- Abnormality of the liver (HP:0001392): An abnormality of the liver. Evidence: TAS. Frequency: Very frequent (HP:0040281). (ORPHA:1304)
- Hyperhidrosis (HP:0000975): Abnormal excessive perspiration (sweating) despite the lack of appropriate stimuli like hot and humid weather. Evidence: TAS. Frequency: Frequent (HP:0040282). (ORPHA:1304)
- Arthritis (HP:0001369): Inflammation of a joint. Evidence: TAS. Frequency: Frequent (HP:0040282). (ORPHA:1304)
- Splenomegaly (HP:0001744): Abnormal increased size of the spleen. Evidence: TAS. Frequency: Frequent (HP:0040282). (ORPHA:1304)
- Weight loss (HP:0001824): Reduction of total body weight. Evidence: TAS. Frequency: Frequent (HP:0040282). (ORPHA:1304)
- Decreased total leukocyte count (HP:0001882): An abnormal decreased number of leukocytes in the blood. Evidence: TAS. Frequency: Frequent (HP:0040282). (ORPHA:1304)
- Anemia (HP:0001903): A reduction in erythrocytes volume or hemoglobin concentration. Evidence: TAS. Frequency: Frequent (HP:0040282). (ORPHA:1304)
- Fever (HP:0001945): Body temperature elevated above the normal range. Evidence: TAS. Frequency: Frequent (HP:0040282). (ORPHA:1304)
- Nausea (HP:0002018): A sensation of unease in the stomach together with an urge to vomit. Evidence: TAS. Frequency: Frequent (HP:0040282). (ORPHA:1304)
- Anorexia (HP:0002039): Lack of desire to eat (loss of appetite). Evidence: TAS. Frequency: Frequent (HP:0040282). (ORPHA:1304)
- Hepatomegaly (HP:0002240): Abnormally increased size of the liver. Evidence: TAS. Frequency: Frequent (HP:0040282). (ORPHA:1304)
- Arthralgia (HP:0002829): Joint pain. Evidence: TAS. Frequency: Frequent (HP:0040282). (ORPHA:1304)
- Septic arthritis (HP:0003095). Evidence: TAS. Frequency: Frequent (HP:0040282). (ORPHA:1304)
- Increased circulating IgG concentration (HP:0003237): An abnormally increased level of immunoglobulin G in blood. Evidence: TAS. Frequency: Frequent (HP:0040282). (ORPHA:1304)
- Elevated erythrocyte sedimentation rate (HP:0003565): An increased erythrocyte sedimentation rate (ESR). The ESR is a test that measures the distance that erythrocytes have fallen after one hour in a vertical column of anticoagulated blood under the influence of gravity. The ESR is a nonspecific finding. An elevation may indicate inflammation or may be caused by any condition that elevates fibrinogen. Evidence: TAS. Frequency: Frequent (HP:0040282). (ORPHA:1304)
- Abnormality of the gastrointestinal tract (HP:0011024): An abnormality of the gastrointestinal tract. Evidence: TAS. Frequency: Frequent (HP:0040282). (ORPHA:1304)
- Elevated circulating C-reactive protein concentration (HP:0011227): The concentration of C-reactive protein in the blood circulation is above the upper limit of normal. Evidence: TAS. Frequency: Frequent (HP:0040282). (ORPHA:1304)
- Fatigue (HP:0012378): A subjective feeling of tiredness characterized by a lack of energy and motivation. Evidence: TAS. Frequency: Frequent (HP:0040282). (ORPHA:1304)
- Abnormal hepatobiliary system physiology (HP:0025155): A functional anomaly of the hepatobiliary system. Evidence: TAS. Frequency: Frequent (HP:0040282). (ORPHA:1304)
- Asthenia (HP:0025406): A state characterized by a feeling of weakness and loss of strength leading to a generalized weakness of the body. Evidence: TAS. Frequency: Frequent (HP:0040282). (ORPHA:1304)
- Epididymitis (HP:0000031): The presence of inflammation of the epididymis. Evidence: TAS. Frequency: Occasional (HP:0040283). (ORPHA:1304)
- Glomerulonephritis (HP:0000099): Inflammation of the renal glomeruli. Evidence: TAS. Frequency: Occasional (HP:0040283). (ORPHA:1304)
- Abnormality of the genitourinary system (HP:0000119): The presence of any abnormality of the genitourinary system. Evidence: TAS. Frequency: Occasional (HP:0040283). (ORPHA:1304)
- Abnormality of the nervous system (HP:0000707): An abnormality of the nervous system. Evidence: TAS. Frequency: Occasional (HP:0040283). (ORPHA:1304)
- Depression (HP:0000716): Frequently experiencing feelings of being down, miserable, and/or hopeless; struggling to recover from these moods; having a pessimistic outlook on the future; feeling a pervasive sense of shame; having a low self-worth; experiencing thoughts of suicide and engaging in suicidal behavior. Evidence: TAS. Frequency: Occasional (HP:0040283). (ORPHA:1304)
- Abnormality of the skin (HP:0000951): An abnormality of the skin. Evidence: TAS. Frequency: Occasional (HP:0040283). (ORPHA:1304)
- Purpura (HP:0000979): Purpura (from Latin: purpura, meaning purple) is the appearance of red or purple discolorations on the skin that do not blanch on applying pressure. They are caused by bleeding underneath the skin. This term refers to an abnormally increased susceptibility to developing purpura. Purpura are larger than petechiae. Evidence: TAS. Frequency: Occasional (HP:0040283). (ORPHA:1304)
- Failure to thrive (HP:0001508): Failure to thrive (FTT) refers to a child whose physical growth is substantially below the norm. Evidence: TAS. Frequency: Occasional (HP:0040283). (ORPHA:1304)
- Small for gestational age (HP:0001518): Smaller than normal size according to sex and gestational age related norms, defined as a weight below the 10th percentile for the gestational age. Evidence: TAS. Frequency: Occasional (HP:0040283). (ORPHA:1304)
- Premature birth (HP:0001622): The birth of a baby of less than 37 weeks of gestational age. Evidence: TAS. Frequency: Occasional (HP:0040283). (ORPHA:1304)
- Thrombocytopenia (HP:0001873): A reduction in the number of circulating thrombocytes. Evidence: TAS. Frequency: Occasional (HP:0040283). (ORPHA:1304)
- Hypersplenism (HP:0001971): A malfunctioning of the spleen in which it prematurely destroys red blood cells. Evidence: TAS. Frequency: Occasional (HP:0040283). (ORPHA:1304)
- Increased total leukocyte count (HP:0001974): An abnormal increase in the number of leukocytes in the blood. Evidence: TAS. Frequency: Occasional (HP:0040283). (ORPHA:1304)
- Morphological central nervous system abnormality (HP:0002011): A structural abnormality of the central nervous system. Evidence: TAS. Frequency: Occasional (HP:0040283). (ORPHA:1304)
- Vomiting (HP:0002013): Forceful ejection of the contents of the stomach through the mouth by means of a series of involuntary spasmic contractions. Evidence: TAS. Frequency: Occasional (HP:0040283). (ORPHA:1304)
- Abdominal pain (HP:0002027): An unpleasant sensation characterized by physical discomfort (such as pricking, throbbing, or aching) and perceived to originate in the abdomen. Evidence: TAS. Frequency: Occasional (HP:0040283). (ORPHA:1304)
- Pneumonia (HP:0002090): Inflammation of any part of the lung parenchyma. Evidence: TAS. Frequency: Occasional (HP:0040283). (ORPHA:1304)
- Pleural effusion (HP:0002202): The presence of an excessive amount of fluid in the pleural cavity. Evidence: TAS. Frequency: Occasional (HP:0040283). (ORPHA:1304)
- Headache (HP:0002315): Cephalgia, or pain sensed in various parts of the head, not confined to the area of distribution of any nerve. Evidence: TAS. Frequency: Occasional (HP:0040283). (ORPHA:1304)
- Lymphadenopathy (HP:0002716): Enlargement (swelling) of a lymph node. Evidence: TAS. Frequency: Occasional (HP:0040283). (ORPHA:1304)
- Osteomyelitis (HP:0002754): Osteomyelitis is an inflammatory process accompanied by bone destruction and caused by an infecting microorganism. Evidence: TAS. Frequency: Occasional (HP:0040283). (ORPHA:1304)
- Rheumatoid factor positive (HP:0002923): The presence in the serum of an autoantibody directed against the Fc portion of IgG. Evidence: TAS. Frequency: Occasional (HP:0040283). (ORPHA:1304)
- Increased circulating IgM concentration (HP:0003496): An abnormally increased level of immunoglobulin M in blood. Evidence: TAS. Frequency: Occasional (HP:0040283). (ORPHA:1304)
- Knee osteoarthritis (HP:0005086). Evidence: TAS. Frequency: Occasional (HP:0040283). (ORPHA:1304)
- Miscarriage (HP:0005268): A pregnancy that ends at a stage in which the fetus is incapable of surviving on its own, defined as the spontaneous loss of a fetus before the 22th week of pregnancy. Evidence: TAS. Frequency: Occasional (HP:0040283). (ORPHA:1304)
- Abnormal bone marrow cell morphology (HP:0005561): An anomaly of the form or number of cells in the bone marrow. Evidence: TAS. Frequency: Occasional (HP:0040283). (ORPHA:1304)
- Hip osteoarthritis (HP:0008843). Evidence: TAS. Frequency: Occasional (HP:0040283). (ORPHA:1304)
- Peripheral neuropathy (HP:0009830): Peripheral neuropathy is a general term for any disorder of the peripheral nervous system. The main clinical features used to classify peripheral neuropathy are distribution, type (mainly demyelinating versus mainly axonal), duration, and course. Evidence: TAS. Frequency: Occasional (HP:0040283). (ORPHA:1304)
- Abnormal respiratory system morphology (HP:0012252): A structural anomaly of the respiratory system. Evidence: TAS. Frequency: Occasional (HP:0040283). (ORPHA:1304)
- Sacroiliac arthritis (HP:0012317): Inflammation of the sacroiliac joint, generally accompanied by lower back pain. Evidence: TAS. Frequency: Occasional (HP:0040283). (ORPHA:1304)
- Bronchitis (HP:0012387): Inflammation of the large airways in the lung including any part of the bronchi from the primary bronchi to the tertiary bronchi. Evidence: TAS. Frequency: Occasional (HP:0040283). (ORPHA:1304)
- Chills (HP:0025143): A sudden sensation of feeling cold. Evidence: TAS. Frequency: Occasional (HP:0040283). (ORPHA:1304)
- Cutaneous cyst (HP:0025245): A hollow mass located in the skin that is surrounded by an epithelium-lined wall and is well demarcated from the adjacent tissue. Cysts are often said to be sac-like and may contain serous liquid or semisolid material. Evidence: TAS. Frequency: Occasional (HP:0040283). (ORPHA:1304)
- Erythematous papule (HP:0030350): A circumscribed, solid elevation of skin with no visible fluid that is reddish (erythematous) in color. Evidence: TAS. Frequency: Occasional (HP:0040283). (ORPHA:1304)
- Granuloma (HP:0032252): A compact, organized collection of mature mononuclear phagocytes, which may be but is not necessarily accompanied by accessory features such as necrosis. Evidence: TAS. Frequency: Occasional (HP:0040283). (ORPHA:1304)
- Immunologic hypersensitivity (HP:0100326): Immunological states where the immune system produces harmful responses upon reexposure to sensitizing antigens. Evidence: TAS. Frequency: Occasional (HP:0040283). (ORPHA:1304)
- Liver abscess (HP:0100523): A localized, circumscribed collection of purulent material (pus) within the liver parenchyma, typically resulting from a bacterial, parasitic, or fungal infection. Unlike hepatitis, which is often diffuse, an abscess is a focal lesion. Evidence: TAS. Frequency: Occasional (HP:0040283). (ORPHA:1304)
- Orchitis (HP:0100796): Testicular inflammation. Evidence: TAS. Frequency: Occasional (HP:0040283). (ORPHA:1304)
- Abnormality of the peripheral nervous system (HP:0410008): Any abnormality of the part of the nervous system that consists of the nerves and ganglia outside of the brain and spinal cord. Evidence: TAS. Frequency: Occasional (HP:0040283). (ORPHA:1304)
- Atypical behavior (HP:0000708): Atypical behavior is an abnormality in a person's actions that can be controlled or modulated by the will of the individual. While abnormal behaviors can be difficult to control, they are distinct from other abnormal actions that cannot be affected by the individual's will. Evidence: TAS. Frequency: Very rare (HP:0040284). (ORPHA:1304)
- Abnormality of the cardiovascular system (HP:0001626): Any abnormality of the cardiovascular system. Evidence: TAS. Frequency: Very rare (HP:0040284). (ORPHA:1304)
- Abnormal aortic valve morphology (HP:0001646): Any abnormality of the aortic valve. Evidence: TAS. Frequency: Very rare (HP:0040284). (ORPHA:1304)
- Pericarditis (HP:0001701): Inflammation of the sac-like covering around the heart (pericardium). Evidence: TAS. Frequency: Very rare (HP:0040284). (ORPHA:1304)
- Thrombocytosis (HP:0001894): Increased numbers of platelets in the peripheral blood. Evidence: TAS. Frequency: Very rare (HP:0040284). (ORPHA:1304)
- Chorea (HP:0002072): Chorea (Greek for 'dance') refers to widespread arrhythmic involuntary movements of a forcible, jerky and restless fashion. It is a random-appearing sequence of one or more discrete involuntary movements or movement fragments. Movements appear random because of variability in timing, duration or location. Each movement may have a distinct start and end. However, movements may be strung together and thus may appear to flow randomly from one muscle group to another. Chorea can involve the trunk, neck, face, tongue, and extremities. Evidence: TAS. Frequency: Very rare (HP:0040284). (ORPHA:1304)
- Transient ischemic attack (HP:0002326). Evidence: TAS. Frequency: Very rare (HP:0040284). (ORPHA:1304)
- Infectious encephalitis (HP:0002383): A disorder of the brain caused by an infectious agent that presents with fever, headache, and an altered level of consciousness. There may also be focal or multifocal neurologic deficits, and focal or generalized seizure activity. Evidence: TAS. Frequency: Very rare (HP:0040284). (ORPHA:1304)
- Thrombophlebitis (HP:0004418): Inflammation of a vein associated with venous thrombosis (blood clot formation within the vein). Evidence: TAS. Frequency: Very rare (HP:0040284). (ORPHA:1304)
- Arteritis (HP:0012089): Arterial inflammation. Evidence: TAS. Frequency: Very rare (HP:0040284). (ORPHA:1304)
- Anterior uveitis (HP:0012122): Inflammation of the uveal tract in which the primary site of inflammation is the anterior chamber. Evidence: TAS. Frequency: Very rare (HP:0040284). (ORPHA:1304)
- Chorioretinitis (HP:0012424): An inflammation of the choroid and retina. Evidence: TAS. Frequency: Very rare (HP:0040284). (ORPHA:1304)
- Myocarditis (HP:0012819): Inflammation of the myocardium. Evidence: TAS. Frequency: Very rare (HP:0040284). (ORPHA:1304)
- Lung abscess (HP:0025044): A circumscribed area of pus or necrotic debris in lung parenchyma, which leads to a cavity, and after formation of bronchopulmonary fistula, can manifest as an air-fluid level inside the cavity. Evidence: TAS. Frequency: Very rare (HP:0040284). (ORPHA:1304)
- Pulmonary granulomatosis (HP:0030250): The presence of multiple granulomata (small nodular inflammatory lesions containing grouped mononuclear phagocytes) in the lung. Evidence: TAS. Frequency: Very rare (HP:0040284). (ORPHA:1304)
- Abnormal cranial nerve physiology (HP:0031910): A functional abnormality affecting one or more of the cranial nerves, which emerge directly from the brain stem. Evidence: TAS. Frequency: Very rare (HP:0040284). (ORPHA:1304)
- Intrarenal abscess (HP:0032620): An encapsulated collection of pus and necrotic material within the renal parenchyma. The destruction of renal parenchyma is associated with suppurative/neutrophil-rich inflammation and necrosis. Evidence: TAS. Frequency: Very rare (HP:0040284). (ORPHA:1304)
- Endocarditis (HP:0100584): An inflammation of the endocardium, the inner layer of the heart, which usually involves the heart valves. Evidence: TAS. Frequency: Very rare (HP:0040284). (ORPHA:1304)
These phenotypes are associated with the disease Brucellosis (ORPHA:1304).